Phenotypes associated with the disease autosomal recessive nonsyndromic hearing loss 71 (OMIM:612789):
- Autosomal recessive inheritance (HP:0000007): A mode of inheritance that is observed for traits related to a gene encoded on one of the autosomes (i.e., the human chromosomes 1-22) in which a trait manifests in individuals with two pathogenic alleles, either homozygotes (two copies of the same mutant allele) or compound heterozygotes (whereby each copy of a gene has a distinct mutant allele). Evidence: PCS. (PMID:19229252)
- Prelingual sensorineural hearing impairment (HP:0000399): A form of sensorineural deafness with either congenital onset or infantile onset, i.e., before the acquisition of speech. Evidence: PCS. (PMID:19229252)